- Autosomal recessive inheritance (HP:0000007): A mode of inheritance that is observed for traits related to a gene encoded on one of the autosomes (i.e., the human chromosomes 1-22) in which a trait manifests in individuals with two pathogenic alleles, either homozygotes (two copies of the same mutant allele) or compound heterozygotes (whereby each copy of a gene has a distinct mutant allele). Evidence: TAS. (OMIM:612775)
- Visual impairment (HP:0000505): Visual impairment (or vision impairment) is vision loss (of a person) to such a degree as to qualify as an additional support need through a significant limitation of visual capability resulting from either disease, trauma, or congenital or degenerative conditions that cannot be corrected by conventional means, such as refractive correction, medication, or surgery. Evidence: TAS. Onset: Childhood onset (HP:0011463). (OMIM:612775)
- Cone/cone-rod dystrophy (HP:0000548). Evidence: TAS. (OMIM:612775)
These phenotypes are associated with the disease cone-rod dystrophy 9 (OMIM:612775).